- Supernumerary naris (HP:0009934): The presence of more than two nostrils. Evidence: TAS. Frequency: Frequent (HP:0040282). (ORPHA:141091)
- Abnormal external nose morphology (HP:0010938): An abnormality of the external nose. Evidence: TAS. Frequency: Frequent (HP:0040282). (ORPHA:141091)
- Abnormal nasal bone morphology (HP:0010939): An abnormality of the nasal bone, comprising the left nasal bone and the right nasal bone. Evidence: TAS. Frequency: Frequent (HP:0040282). (ORPHA:141091)
- Orofacial cleft (HP:0000202): The presence of a cleft (gap, opening, or groove) in the oral cavity, including cleft of the upper lip and/or cleft of the palate. Cleft of the upper lip is visible as a groove or fissure in the lip, most frequently due to a congenital failure of the maxillary and median nasal processes to fuse. Cleft palate is characterized by a grooved depression or fissure in the roof of the mouth, most often resulting from a congenital failure of the palate to fuse properly. Clefts of the lip and palate can occur individually or together. It is preferable to code each defect separately. Evidence: TAS. Frequency: Occasional (HP:0040283). (ORPHA:141091)
- Hypertelorism (HP:0000316): Interpupillary distance more than 2 SD above the mean (alternatively, the appearance of an increased interpupillary distance or widely spaced eyes). Evidence: TAS. Frequency: Occasional (HP:0040283). (ORPHA:141091)
- Abnormality of the glabella (HP:0002056): An abnormality of the glabella. Evidence: TAS. Frequency: Occasional (HP:0040283). (ORPHA:141091)
- Abnormal skull base morphology (HP:0002693): An abnormality of the base of the skull, which forms the floor of the cranial cavity and separates the brain from other facial structures. The skull base is made up of five bones: the ethmoid, sphenoid, occipital, paired frontal, and paired parietal bones, and is subdivided into 3 regions: the anterior, middle, and posterior cranial fossae. The petro-occipital fissure subdivides the middle cranial fossa into 1 central component and 2 lateral components. Evidence: TAS. Frequency: Occasional (HP:0040283). (ORPHA:141091)
- Lateral ventricle dilatation (HP:0006956). Evidence: TAS. Frequency: Occasional (HP:0040283). (ORPHA:141091)
- Abnormal third ventricle morphology (HP:0010951): An abnormality of the third ventricle. Evidence: TAS. Frequency: Occasional (HP:0040283). (ORPHA:141091)
These phenotypes are associated with the disease Polyrrhinia (ORPHA:141091).